Phenotypes associated with the disease Pili gemini (ORPHA:79492):
- Hair shafts flattened at irregular intervals and twisted through 180 degrees about their axes (HP:0003329). Evidence: TAS. Frequency: Obligate (HP:0040280). (ORPHA:79492)
- Abnormal hairshaft morphology (HP:0003328): An abnormal structure of the hairshaft, i.e., of the nongrowing portion of a hair that protrudes from the skin. Evidence: TAS. Frequency: Frequent (HP:0040282). (ORPHA:79492)